Phenotypes associated with the disease anodontia (OMIM:206780):
- Autosomal recessive inheritance (HP:0000007): A mode of inheritance that is observed for traits related to a gene encoded on one of the autosomes (i.e., the human chromosomes 1-22) in which a trait manifests in individuals with two pathogenic alleles, either homozygotes (two copies of the same mutant allele) or compound heterozygotes (whereby each copy of a gene has a distinct mutant allele). Evidence: IEA. (OMIM:206780)
- Anodontia (HP:0000674): The absence of all teeth from the normal series by a failure to develop. Evidence: TAS. (OMIM:206780)